- Microdontia (HP:0000691): Decreased size of the teeth, which can be defined as a mesiodistal tooth diameter (width) more than 2 SD below mean. Alternatively, an apparently decreased maximum width of tooth. Evidence: PCS. Frequency: 1/7. (PMID:26416033)
- Selective tooth agenesis (HP:0001592): Agenesis specifically affecting one of the classes incisor, premolar, or molar. Evidence: PCS. Frequency: 6/7. (PMID:26416033)
- Taurodontia (HP:0000679): Increased volume of dental pulp of permanent molar characterized by a crown body-root ratio equal or larger than 1:1 or an elongated pulp chambers and apical displacement of the bifurcation or trifurcation of the roots. Evidence: PCS. Frequency: 1/7. (PMID:26416033)
- Autosomal dominant inheritance (HP:0000006): A mode of inheritance that is observed for traits related to a gene encoded on one of the autosomes (i.e., the human chromosomes 1-22) in which a trait manifests in heterozygotes. In the context of medical genetics, an autosomal dominant disorder is caused when a single copy of the mutant allele is present. Males and females are affected equally, and can both transmit the disorder with a risk of 50% for each child of inheriting the mutant allele. Evidence: PCS. (PMID:26416033)
These phenotypes are associated with the disease tooth agenesis, selective, 9 (OMIM:617275).